Phenotypes associated with the disease Pemphigoid gestationis (ORPHA:63275):
- Pruritus (HP:0000989): Pruritus is an itch or a sensation that makes a person want to scratch. This term refers to an abnormally increased disposition to experience pruritus. Evidence: TAS. Frequency: Very frequent (HP:0040281). (ORPHA:63275)
- Failure to thrive (HP:0001508): Failure to thrive (FTT) refers to a child whose physical growth is substantially below the norm. Evidence: TAS. Frequency: Frequent (HP:0040282). (ORPHA:63275)
- Intrauterine growth retardation (HP:0001511): An abnormal restriction of fetal growth with fetal weight below the tenth percentile for gestational age. Evidence: TAS. Frequency: Frequent (HP:0040282). (ORPHA:63275)
- Premature birth (HP:0001622): The birth of a baby of less than 37 weeks of gestational age. Evidence: TAS. Frequency: Very frequent (HP:0040281). (ORPHA:63275)
- Abnormal blistering of the skin (HP:0008066): The presence of one or more bullae on the skin, defined as fluid-filled blisters more than 5 mm in diameter with thin walls. Evidence: TAS. Frequency: Very frequent (HP:0040281). (ORPHA:63275)
- Skin vesicle (HP:0200037): A circumscribed, fluid-containing, epidermal elevation less than 10mm in diameter at the widest point that (i) Contain serous exudates or serum mixed with blood or pus; (ii) Are discrete, grouped, irregularly distributed, or linear as in Rhus dermatitis; (iii) Are short-lived. Vesicles may break spontaneously or evolve into bullae by enlarging or coalescing with other vesicles. Evidence: TAS. Frequency: Very frequent (HP:0040281). (ORPHA:63275)